Phenotypes associated with the disease polyposis, intestinal, scattered and discrete (OMIM:175400):
- Discrete intestinal polyps (HP:0005238). Evidence: IEA. (OMIM:175400)
- Autosomal dominant inheritance (HP:0000006): A mode of inheritance that is observed for traits related to a gene encoded on one of the autosomes (i.e., the human chromosomes 1-22) in which a trait manifests in heterozygotes. In the context of medical genetics, an autosomal dominant disorder is caused when a single copy of the mutant allele is present. Males and females are affected equally, and can both transmit the disorder with a risk of 50% for each child of inheriting the mutant allele. Evidence: IEA. (OMIM:175400)